- Ambiguous genitalia (HP:0000062): A genital phenotype that is not clearly assignable to a single gender. Ambiguous genitalia can be evaluated using the Prader scale: Prader 0: Normal female external genitalia. Prader 1: Female external genitalia with clitoromegaly. Prader 2: Clitoromegaly with partial labial fusion forming a funnel-shaped urogenital sinus. Prader 3: Increased phallic enlargement. Complete labioscrotal fusion forming a urogenital sinus with a single opening. Prader 4: Complete scrotal fusion with urogenital opening at the base or on the shaft of the phallus. Prader 5: Normal male external genitalia. The diagnosis of ambiguous genitalia is made for Prader 1-4. Evidence: IEA. (OMIM:613571)
- Increased circulating ACTH level (HP:0003154): An abnormal increased in the concentration of corticotropin, also known as adrenocorticotropic hormone (ACTH), in the blood. Evidence: IEA. (OMIM:613571)
- Autosomal recessive inheritance (HP:0000007): A mode of inheritance that is observed for traits related to a gene encoded on one of the autosomes (i.e., the human chromosomes 1-22) in which a trait manifests in individuals with two pathogenic alleles, either homozygotes (two copies of the same mutant allele) or compound heterozygotes (whereby each copy of a gene has a distinct mutant allele). Evidence: PCS. (PMID:18559916)
- Congenital adrenal hyperplasia (HP:0008258): A type of adrenal hyperplasia with congenital onset. Evidence: IEA. (OMIM:613571)
These phenotypes are associated with the disease congenital adrenal hyperplasia due to cytochrome P450 oxidoreductase deficiency (OMIM:613571).